- X-linked inheritance (HP:0001417): A mode of inheritance that is observed for traits related to a gene encoded on the X chromosome. Evidence: IEA. (OMIM:300211)
- Muscle weakness (HP:0001324): Reduced strength of muscles. Evidence: IEA. Frequency: Obligate (HP:0040280). (OMIM:300211)
These phenotypes are associated with the disease episodic muscle weakness, X-linked (OMIM:300211).